- Onychomadesis (HP:0025088): Complete shedding (separation) of the nail from the proximal matrix. Onychomadesis is the proximal separation of the nail plate from the nail matrix due to a temporary cessation of nail growth. Evidence: TAS. (OMIM:177900)
- Onycholysis (HP:0001806): Detachment of the nail from the nail bed. Evidence: TAS. (OMIM:177900)
- Non-Mendelian inheritance (HP:0001426): A mode of inheritance that depends on genetic determinants in more than one gene. Evidence: TAS. (OMIM:177900)
- Nail pits (HP:0001803): Small (typically about 1 mm or less in size) depressions on the dorsal nail surface. Evidence: TAS. (OMIM:177900)
- Psoriasiform dermatitis (HP:0003765): A skin abnormality characterized by redness and irritation, with thick, red skin that displays flaky, silver-white patches (scales). Evidence: TAS. (OMIM:177900)
- Arthritis (HP:0001369): Inflammation of a joint. Evidence: PCS. (OMIM:177900)
These phenotypes are associated with the disease psoriasis 1, susceptibility to (OMIM:177900).